Phenotypes associated with the disease Fetal hemoglobin quantitative trait locus 1 (OMIM:141749):
- Persistence of hemoglobin F (HP:0011904): Hemoglobin F (HbF) contains two globin alpha chains and two globin gamma chains. It is the main form of hemoglobin in the fetus during the last seven months of intrauterine development and in the half year of postnatal life. In adults it normally makes up less than one percent of all hemoglobin. This term refers to an increase in HbF above this limit. In beta thalassemia major, it may represent over 90 percent of all hemoglobin, and in beta thalassemia minor it may make up between 0.5 to 4 percent. Evidence: TAS. (OMIM:141749)
- Autosomal dominant inheritance (HP:0000006): A mode of inheritance that is observed for traits related to a gene encoded on one of the autosomes (i.e., the human chromosomes 1-22) in which a trait manifests in heterozygotes. In the context of medical genetics, an autosomal dominant disorder is caused when a single copy of the mutant allele is present. Males and females are affected equally, and can both transmit the disorder with a risk of 50% for each child of inheriting the mutant allele. Evidence: TAS. (OMIM:141749)